- Abnormality of blood and blood-forming tissues (HP:0001871): An abnormality of the hematopoietic system. Evidence: IEA. (OMIM:306930)
- X-linked inheritance (HP:0001417): A mode of inheritance that is observed for traits related to a gene encoded on the X chromosome. Evidence: IEA. (OMIM:306930)
These phenotypes are associated with the disease hemopoietic proliferation (OMIM:306930).